- Childhood onset (HP:0011463): Onset of disease at the age of between 1 and 5 years. Evidence: PCS. Frequency: 10/10. (PMID:21695231)
- High myopia (HP:0011003): A severe form of myopia with greater than -6.00 diopters. Evidence: PCS. Frequency: 10/10. (PMID:21695231)
- Autosomal dominant inheritance (HP:0000006): A mode of inheritance that is observed for traits related to a gene encoded on one of the autosomes (i.e., the human chromosomes 1-22) in which a trait manifests in heterozygotes. In the context of medical genetics, an autosomal dominant disorder is caused when a single copy of the mutant allele is present. Males and females are affected equally, and can both transmit the disorder with a risk of 50% for each child of inheriting the mutant allele. Evidence: PCS. (PMID:21695231)
These phenotypes are associated with the disease myopia 21, autosomal dominant (OMIM:614167).